- Hypospadias (HP:0000047): Abnormal position of urethral meatus on the ventral penile shaft (underside) characterized by displacement of the urethral meatus from the tip of the glans penis to the ventral surface of the penis, scrotum, or perineum. Evidence: TAS. Frequency: Very frequent (HP:0040281). (ORPHA:217346)
- Microcephaly (HP:0000252): Head circumference below 2 standard deviations below the mean for age and gender. Evidence: TAS. Frequency: Very frequent (HP:0040281). (ORPHA:217346)
- Delayed speech and language development (HP:0000750): A degree of language development that is significantly below the norm for a child of a specified age. Evidence: TAS. Frequency: Very frequent (HP:0040281). (ORPHA:217346)
- Aplasia cutis congenita (HP:0001057): A developmental defect resulting in the congenital absence of skin in multiple or solitary non-inflammatory, well-demarcated, oval or circular ulcers with a diameter of about 1 to 2 cm. Aplasia cutis congenita most commonly occurs on the scalp, but may present in the face, trunk, or limbs. Evidence: TAS. Frequency: Very frequent (HP:0040281). (ORPHA:217346)
- Intellectual disability (HP:0001249): The term intellectual disability or intellectual developmental disorder is used to describe significantly sub-average intellectual and adaptive functioning based on clinical assessment and as measured by individually administered, appropriately normed, standardized and validated tests of intellectual functioning and adaptive behavior, with onset during the developmental period from infancy through adolescence. Evidence: TAS. Frequency: Very frequent (HP:0040281). (ORPHA:217346)
- Failure to thrive (HP:0001508): Failure to thrive (FTT) refers to a child whose physical growth is substantially below the norm. Evidence: TAS. Frequency: Very frequent (HP:0040281). (ORPHA:217346)
- Growth delay (HP:0001510): A deficiency or slowing down of growth pre- and postnatally. Evidence: TAS. Frequency: Very frequent (HP:0040281). (ORPHA:217346)
- Intrauterine growth retardation (HP:0001511): An abnormal restriction of fetal growth with fetal weight below the tenth percentile for gestational age. Evidence: TAS. Frequency: Very frequent (HP:0040281). (ORPHA:217346)
- Clinodactyly of the 5th finger (HP:0004209): Clinodactyly refers to a bending or curvature of the fifth finger in the radial direction (i.e., towards the 4th finger). Evidence: TAS. Frequency: Very frequent (HP:0040281). (ORPHA:217346)
- Cachexia (HP:0004326): Severe weight loss, wasting of muscle, loss of appetite, and general debility related to a chronic disease. Evidence: TAS. Frequency: Very frequent (HP:0040281). (ORPHA:217346)
- Feeding difficulties (HP:0011968): Impaired ability to eat related to problems gathering food and getting ready to suck, chew, or swallow it. Evidence: TAS. Frequency: Very frequent (HP:0040281). (ORPHA:217346)
- Cryptorchidism (HP:0000028): Testis in inguinal canal. That is, absence of one or both testes from the scrotum owing to failure of the testis or testes to descend through the inguinal canal to the scrotum. Evidence: TAS. Frequency: Frequent (HP:0040282). (ORPHA:217346)
- Thin vermilion border (HP:0000233): Height of the vermilion of the medial part of the lip more than 2 SD below the mean, or apparently reduced height of the vermilion of the lip in the frontal view. The vermilion is the red part of the lips (and confusingly, the vermilion itself is also often referred to as being equivalent the lips). Evidence: TAS. Frequency: Frequent (HP:0040282). (ORPHA:217346)
- Long face (HP:0000276): Facial height (length) is more than 2 standard deviations above the mean (objective); or, an apparent increase in the height (length) of the face (subjective). Evidence: TAS. Frequency: Frequent (HP:0040282). (ORPHA:217346)
- Retrognathia (HP:0000278): An abnormality in which the mandible is mislocalised posteriorly. Evidence: TAS. Frequency: Frequent (HP:0040282). (ORPHA:217346)
- High forehead (HP:0000348): An abnormally increased height of the forehead. Evidence: TAS. Frequency: Frequent (HP:0040282). (ORPHA:217346)
- Underdeveloped nasal alae (HP:0000430): Thinned, deficient, or excessively arched ala nasi. Evidence: TAS. Frequency: Frequent (HP:0040282). (ORPHA:217346)
- Dry skin (HP:0000958): Skin characterized by the lack of natural or normal moisture. Evidence: TAS. Frequency: Frequent (HP:0040282). (ORPHA:217346)
- Thin skin (HP:0000963): Reduction in thickness of the skin, generally associated with a loss of suppleness and elasticity of the skin. Evidence: TAS. Frequency: Frequent (HP:0040282). (ORPHA:217346)
- Toe syndactyly (HP:0001770): Webbing or fusion of the toes, involving soft parts only or including bone structure. Bony fusions are referred to as "bony" Syndactyly if the fusion occurs in a radio-ulnar axis. Fusions of bones of the toes in a proximo-distal axis are referred to as "Symphalangism". Evidence: TAS. Frequency: Frequent (HP:0040282). (ORPHA:217346)
- Toe clinodactyly (HP:0001863): Bending or curvature of a toe in the tibial direction (i.e., towards the big toe). Evidence: TAS. Frequency: Frequent (HP:0040282). (ORPHA:217346)
- Nail dysplasia (HP:0002164): The presence of developmental dysplasia of the nail. Evidence: TAS. Frequency: Frequent (HP:0040282). (ORPHA:217346)
- Recurrent respiratory infections (HP:0002205): An increased susceptibility to respiratory infections as manifested by a history of recurrent respiratory infections. Evidence: TAS. Frequency: Frequent (HP:0040282). (ORPHA:217346)
- Fine hair (HP:0002213): Hair that is fine or thin to the touch. Evidence: TAS. Frequency: Frequent (HP:0040282). (ORPHA:217346)
- Supernumerary nipple (HP:0002558): Presence of more than two nipples. Evidence: TAS. Frequency: Frequent (HP:0040282). (ORPHA:217346)
- Sparse lateral eyebrow (HP:0005338): Decreased density/number and/or decreased diameter of lateral eyebrow hairs. Evidence: TAS. Frequency: Frequent (HP:0040282). (ORPHA:217346)
- Finger syndactyly (HP:0006101): Webbing or fusion of the fingers, involving soft parts only or including bone structure. Bony fusions are referred to as "bony" Syndactyly if the fusion occurs in a radio-ulnar axis. Fusions of bones of the fingers in a proximo-distal axis are referred to as "Symphalangism". Evidence: TAS. Frequency: Frequent (HP:0040282). (ORPHA:217346)
- Wide intermamillary distance (HP:0006610): A larger than usual distance between the left and right nipple. Evidence: TAS. Frequency: Frequent (HP:0040282). (ORPHA:217346)
- Sparse hair (HP:0008070): Reduced density of hairs. Evidence: TAS. Frequency: Frequent (HP:0040282). (ORPHA:217346)
- Broad columella (HP:0010761): Increased width of the columella. Evidence: TAS. Frequency: Frequent (HP:0040282). (ORPHA:217346)
- Sparse or absent eyelashes (HP:0200102). Evidence: TAS. Frequency: Frequent (HP:0040282). (ORPHA:217346)
- Bifid scrotum (HP:0000048): Midline indentation or cleft of the scrotum. Evidence: TAS. Frequency: Occasional (HP:0040283). (ORPHA:217346)
- Wide mouth (HP:0000154): Distance between the oral commissures more than 2 SD above the mean. Alternatively, an apparently increased width of the oral aperture (subjective). Evidence: TAS. Frequency: Occasional (HP:0040283). (ORPHA:217346)
- Hearing impairment (HP:0000365): A decreased magnitude of the sensory perception of sound. Evidence: TAS. Frequency: Occasional (HP:0040283). (ORPHA:217346)
- Microcornea (HP:0000482): A congenital abnormality of the cornea in which the cornea and the anterior segment of the eye are smaller than normal. The horizontal diameter of the cornea does not reach 10 mm even in adulthood. Evidence: TAS. Frequency: Occasional (HP:0040283). (ORPHA:217346)
- Cataract (HP:0000518): A cataract is an opacity or clouding that develops in the crystalline lens of the eye or in its capsule. Evidence: TAS. Frequency: Occasional (HP:0040283). (ORPHA:217346)
- Congenital hip dislocation (HP:0001374). Evidence: TAS. Frequency: Occasional (HP:0040283). (ORPHA:217346)
- Ventricular septal defect (HP:0001629): A hole between the two bottom chambers (ventricles) of the heart. The defect is centered around the most superior aspect of the ventricular septum. Evidence: TAS. Frequency: Occasional (HP:0040283). (ORPHA:217346)
- Solitary median maxillary central incisor (HP:0006315): A single maxillary central incisor positioned in the midline with morphological symmetry of the crown and bordered by lateral incisors. Evidence: TAS. Frequency: Occasional (HP:0040283). (ORPHA:217346)
- Abnormal cardiovascular system morphology (HP:0030680): Any structural anomaly of the heart and blood vessels. Evidence: TAS. Frequency: Occasional (HP:0040283). (ORPHA:217346)
These phenotypes are associated with the disease 19q13.11 microdeletion syndrome (ORPHA:217346).